- Hypertelorism (HP:0000316): Interpupillary distance more than 2 SD above the mean (alternatively, the appearance of an increased interpupillary distance or widely spaced eyes). Evidence: IEA. (OMIM:145400)
- Autosomal dominant inheritance (HP:0000006): A mode of inheritance that is observed for traits related to a gene encoded on one of the autosomes (i.e., the human chromosomes 1-22) in which a trait manifests in heterozygotes. In the context of medical genetics, an autosomal dominant disorder is caused when a single copy of the mutant allele is present. Males and females are affected equally, and can both transmit the disorder with a risk of 50% for each child of inheriting the mutant allele. Evidence: IEA. (OMIM:145400)
These phenotypes are associated with the disease HYPERTELORISM (OMIM:145400).